Phenotypes associated with the disease 17q21.31 microduplication syndrome (ORPHA:217340):
- Abnormality of the dentition (HP:0000164): Any abnormality of the teeth. Evidence: TAS. Frequency: Frequent (HP:0040282). (ORPHA:217340)
- High palate (HP:0000218): Height of the palate more than 2 SD above the mean (objective) or palatal height at the level of the first permanent molar more than twice the height of the teeth (subjective). Evidence: TAS. Frequency: Frequent (HP:0040282). (ORPHA:217340)
- Microcephaly (HP:0000252): Head circumference below 2 standard deviations below the mean for age and gender. Evidence: TAS. Frequency: Occasional (HP:0040283). (ORPHA:217340)
- Malar flattening (HP:0000272): Underdevelopment of the malar prominence of the jugal bone (zygomatic bone in mammals), appreciated in profile, frontal view, and/or by palpation. Evidence: TAS. Frequency: Frequent (HP:0040282). (ORPHA:217340)
- Epicanthus (HP:0000286): A fold of skin starting above the medial aspect of the upper eyelid and arching downward to cover, pass in front of and lateral to the medial canthus. Evidence: TAS. Frequency: Occasional (HP:0040283). (ORPHA:217340)
- Short philtrum (HP:0000322): Distance between nasal base and midline upper lip vermilion border more than 2 SD below the mean. Alternatively, an apparently decreased distance between nasal base and midline upper lip vermilion border. Evidence: TAS. Frequency: Frequent (HP:0040282). (ORPHA:217340)
- Micrognathia (HP:0000347): Developmental hypoplasia of the mandible. Evidence: TAS. Frequency: Occasional (HP:0040283). (ORPHA:217340)
- Abnormality of the outer ear (HP:0000356): An abnormality of the external ear. Evidence: TAS. Frequency: Very frequent (HP:0040281). (ORPHA:217340)
- Anteverted nares (HP:0000463): Anteriorly-facing nostrils viewed with the head in the Frankfurt horizontal and the eyes of the observer level with the eyes of the subject. This gives the appearance of an upturned nose (upturned nasal tip). Evidence: TAS. Frequency: Frequent (HP:0040282). (ORPHA:217340)
- Thick eyebrow (HP:0000574): Increased density/number and/or increased diameter of eyebrow hairs. Evidence: TAS. Frequency: Occasional (HP:0040283). (ORPHA:217340)
- Synophrys (HP:0000664): Meeting of the medial eyebrows in the midline. Evidence: TAS. Frequency: Occasional (HP:0040283). (ORPHA:217340)
- Autism (HP:0000717): Autism is a neurodevelopmental disorder characterized by impaired social interaction and communication, and by restricted and repetitive behavior. Autism begins in childhood. It is marked by the presence of markedly abnormal or impaired development in social interaction and communication and a markedly restricted repertoire of activity and interest. Manifestations of the disorder vary greatly depending on the developmental level and chronological age of the individual (DSM-IV). Evidence: TAS. Frequency: Very frequent (HP:0040281). (ORPHA:217340)
- Compulsive behaviors (HP:0000722): Behavior that consists of repetitive acts, characterized by the feeling that one "has to" perform them, while being aware that these acts are not in line with one's overall goal. Evidence: TAS. Frequency: Occasional (HP:0040283). (ORPHA:217340)
- Autistic behavior (HP:0000729): Persistent deficits in social interaction and communication and interaction as well as a markedly restricted repertoire of activity and interest as well as repetitive patterns of behavior. Evidence: TAS. Frequency: Frequent (HP:0040282). (ORPHA:217340)
- Delayed puberty (HP:0000823): Passing the age when puberty normally occurs with no physical or hormonal signs of the onset of puberty. Evidence: TAS. Frequency: Occasional (HP:0040283). (ORPHA:217340)
- Intellectual disability (HP:0001249): The term intellectual disability or intellectual developmental disorder is used to describe significantly sub-average intellectual and adaptive functioning based on clinical assessment and as measured by individually administered, appropriately normed, standardized and validated tests of intellectual functioning and adaptive behavior, with onset during the developmental period from infancy through adolescence. Evidence: TAS. Frequency: Very frequent (HP:0040281). (ORPHA:217340)
- Hypotonia (HP:0001252): Hypotonia is an abnormally low muscle tone (the amount of tension or resistance to movement in a muscle). Even when relaxed, muscles have a continuous and passive partial contraction which provides some resistance to passive stretching. Hypotonia thus manifests as diminished resistance to passive stretching. Hypotonia is not the same as muscle weakness, although the two conditions can co-exist. Evidence: TAS. Frequency: Frequent (HP:0040282). (ORPHA:217340)
- Global developmental delay (HP:0001263): A delay in the achievement of motor or mental milestones in the domains of development of a child, including motor skills, speech and language, cognitive skills, and social and emotional skills. This term should only be used to describe children younger than five years of age. Evidence: TAS. Frequency: Very frequent (HP:0040281). (ORPHA:217340)
- Failure to thrive (HP:0001508): Failure to thrive (FTT) refers to a child whose physical growth is substantially below the norm. Evidence: TAS. Frequency: Occasional (HP:0040283). (ORPHA:217340)
- Toe syndactyly (HP:0001770): Webbing or fusion of the toes, involving soft parts only or including bone structure. Bony fusions are referred to as "bony" Syndactyly if the fusion occurs in a radio-ulnar axis. Fusions of bones of the toes in a proximo-distal axis are referred to as "Symphalangism". Evidence: TAS. Frequency: Frequent (HP:0040282). (ORPHA:217340)
- Sandal gap (HP:0001852): A widely spaced gap between the first toe (the great toe) and the second toe. Evidence: TAS. Frequency: Occasional (HP:0040283). (ORPHA:217340)
- Generalized hirsutism (HP:0002230): Abnormally increased hair growth over much of the entire body. Evidence: TAS. Frequency: Frequent (HP:0040282). (ORPHA:217340)
- Short nose (HP:0003196): Distance from nasion to subnasale more than two standard deviations below the mean, or alternatively, an apparently decreased length from the nasal root to the nasal tip. Evidence: TAS. Frequency: Frequent (HP:0040282). (ORPHA:217340)
- Clinodactyly of the 5th finger (HP:0004209): Clinodactyly refers to a bending or curvature of the fifth finger in the radial direction (i.e., towards the 4th finger). Evidence: TAS. Frequency: Frequent (HP:0040282). (ORPHA:217340)
- Attention deficit hyperactivity disorder (HP:0007018): Attention deficit hyperactivity disorder (ADHD) manifests at age 2-3 years or by first grade at the latest. The main symptoms are distractibility, impulsivity, hyperactivity, and often trouble organizing tasks and projects, difficulty going to sleep, and social problems from being aggressive, loud, or impatient. Evidence: TAS. Frequency: Frequent (HP:0040282). (ORPHA:217340)